- Split hand (HP:0001171): A condition in which middle parts of the hand (fingers and metacarpals) are missing giving a cleft appearance. The severity is very variable ranging from slightly hypoplastic middle fingers over absent middle fingers as far as oligo- or monodactyl hands. Evidence: TAS. Frequency: Frequent (HP:0040282). (ORPHA:2492)
- Premature birth (HP:0001622): The birth of a baby of less than 37 weeks of gestational age. Evidence: TAS. Frequency: Frequent (HP:0040282). (ORPHA:2492)
- Abnormality of the cardiovascular system (HP:0001626): Any abnormality of the cardiovascular system. Evidence: TAS. Frequency: Frequent (HP:0040282). (ORPHA:2492)
- Respiratory insufficiency (HP:0002093). Evidence: TAS. Frequency: Frequent (HP:0040282). (ORPHA:2492)
- Abnormal fibula morphology (HP:0002991): An anomaly of the calf bone (fibula), one of the two bones of the calf. Evidence: TAS. Frequency: Very frequent (HP:0040281). (ORPHA:2492)
- Abnormal tibia morphology (HP:0002992): Abnormality of the tibia (shinbone). Evidence: TAS. Frequency: Very frequent (HP:0040281). (ORPHA:2492)
- Absent hand (HP:0004050): The total absence of the hand, with no bony elements distal to the radius or ulna. Evidence: TAS. Frequency: Very frequent (HP:0040281). (ORPHA:2492)
- Short stature (HP:0004322): A height below that which is expected according to age and gender norms. Although there is no universally accepted definition of short stature, many refer to "short stature" as height more than 2 standard deviations below the mean for age and gender (or below the 3rd percentile for age and gender dependent norms). Evidence: TAS. Frequency: Frequent (HP:0040282). (ORPHA:2492)
- Finger syndactyly (HP:0006101): Webbing or fusion of the fingers, involving soft parts only or including bone structure. Bony fusions are referred to as "bony" Syndactyly if the fusion occurs in a radio-ulnar axis. Fusions of bones of the fingers in a proximo-distal axis are referred to as "Symphalangism". Evidence: TAS. Frequency: Frequent (HP:0040282). (ORPHA:2492)
- Tarsal synostosis (HP:0008368): Synostosis (bony fusion) involving one or more bones of the tarsus (calcaneus, talus, cuboid, navicular, cuneiiform bones). Evidence: TAS. Frequency: Frequent (HP:0040282). (ORPHA:2492)
These phenotypes are associated with the disease FATCO syndrome (ORPHA:2492).